- Posteriorly rotated ears (HP:0000358): A type of abnormal location of the ears in which the position of the ears is characterized by posterior rotation (the superior part of the ears is rotated towards the back of the head, and the inferior part of the ears towards the front). Evidence: TAS. Frequency: Very frequent (HP:0040281). (ORPHA:1642)
- Short nose (HP:0003196): Distance from nasion to subnasale more than two standard deviations below the mean, or alternatively, an apparently decreased length from the nasal root to the nasal tip. Evidence: TAS. Frequency: Very frequent (HP:0040281). (ORPHA:1642)
- Microtia (HP:0008551): Underdevelopment of the external ear. Evidence: TAS. Frequency: Very frequent (HP:0040281). (ORPHA:1642)
- Abnormal antihelix morphology (HP:0009738): An abnormality of the antihelix. Evidence: TAS. Frequency: Very frequent (HP:0040281). (ORPHA:1642)
- Midface retrusion (HP:0011800): Posterior positions and/or vertical shortening of the infraorbital and perialar regions, or increased concavity of the face and/or reduced nasolabial angle. Evidence: TAS. Frequency: Very frequent (HP:0040281). (ORPHA:1642)
- Hypospadias (HP:0000047): Abnormal position of urethral meatus on the ventral penile shaft (underside) characterized by displacement of the urethral meatus from the tip of the glans penis to the ventral surface of the penis, scrotum, or perineum. Evidence: TAS. Frequency: Frequent (HP:0040282). (ORPHA:1642)
- Hypoplastic labia majora (HP:0000059): Undergrowth of the outer labia. Evidence: TAS. Frequency: Frequent (HP:0040282). (ORPHA:1642)
- Abnormality of the dentition (HP:0000164): Any abnormality of the teeth. Evidence: TAS. Frequency: Frequent (HP:0040282). (ORPHA:1642)
- Epicanthus (HP:0000286): A fold of skin starting above the medial aspect of the upper eyelid and arching downward to cover, pass in front of and lateral to the medial canthus. Evidence: TAS. Frequency: Frequent (HP:0040282). (ORPHA:1642)
- Brachydactyly (HP:0001156): Digits that appear disproportionately short compared to the hand/foot. The word brachydactyly is used here to describe a series distinct patterns of shortened digits (brachydactyly types A-E). This is the sense used here. Evidence: TAS. Frequency: Frequent (HP:0040282). (ORPHA:1642)
- Wide intermamillary distance (HP:0006610): A larger than usual distance between the left and right nipple. Evidence: TAS. Frequency: Frequent (HP:0040282). (ORPHA:1642)
- Aplasia/Hypoplasia of the earlobes (HP:0009906): Absence or underdevelopment of the ear lobes. Evidence: TAS. Frequency: Frequent (HP:0040282). (ORPHA:1642)
- Abnormal helix morphology (HP:0011039): An abnormality of the helix. The helix is the outer rim of the ear that extends from the insertion of the ear on the scalp (root) to the termination of the cartilage at the earlobe. Evidence: TAS. Frequency: Frequent (HP:0040282). (ORPHA:1642)
- Enlarged thorax (HP:0100625). Evidence: TAS. Frequency: Frequent (HP:0040282). (ORPHA:1642)
- Hernia (HP:0100790). Evidence: TAS. Frequency: Frequent (HP:0040282). (ORPHA:1642)
- Cleft palate (HP:0000175): Cleft palate is a developmental defect of the palate resulting from a failure of fusion of the palatine processes and manifesting as a separation of the roof of the mouth (soft and hard palate). Evidence: TAS. Frequency: Occasional (HP:0040283). (ORPHA:1642)
- Abnormal cardiovascular system morphology (HP:0030680): Any structural anomaly of the heart and blood vessels. Evidence: TAS. Frequency: Occasional (HP:0040283). (ORPHA:1642)
- Trigonocephaly (HP:0000243): Wedge-shaped, or triangular head, with the apex of the triangle at the midline of the forehead and the base of the triangle at the occiput. Evidence: TAS. Frequency: Very frequent (HP:0040281). (ORPHA:1642)
- Hypertelorism (HP:0000316): Interpupillary distance more than 2 SD above the mean (alternatively, the appearance of an increased interpupillary distance or widely spaced eyes). Evidence: TAS. Frequency: Very frequent (HP:0040281). (ORPHA:1642)
- Wide nasal bridge (HP:0000431): Increased breadth of the nasal bridge (and with it, the nasal root). Evidence: TAS. Frequency: Very frequent (HP:0040281). (ORPHA:1642)
- Short neck (HP:0000470): Diminished length of the neck. Evidence: TAS. Frequency: Very frequent (HP:0040281). (ORPHA:1642)
- Proptosis (HP:0000520): An eye that is protruding anterior to the plane of the face to a greater extent than is typical. Evidence: TAS. Frequency: Very frequent (HP:0040281). (ORPHA:1642)
- Upslanted palpebral fissure (HP:0000582): The palpebral fissure inclination is more than two standard deviations above the mean for age (objective); or, the inclination of the palpebral fissure is greater than typical for age. Evidence: TAS. Frequency: Very frequent (HP:0040281). (ORPHA:1642)
- Intellectual disability (HP:0001249): The term intellectual disability or intellectual developmental disorder is used to describe significantly sub-average intellectual and adaptive functioning based on clinical assessment and as measured by individually administered, appropriately normed, standardized and validated tests of intellectual functioning and adaptive behavior, with onset during the developmental period from infancy through adolescence. Evidence: TAS. Frequency: Very frequent (HP:0040281). (ORPHA:1642)
- Hypotonia (HP:0001252): Hypotonia is an abnormally low muscle tone (the amount of tension or resistance to movement in a muscle). Even when relaxed, muscles have a continuous and passive partial contraction which provides some resistance to passive stretching. Hypotonia thus manifests as diminished resistance to passive stretching. Hypotonia is not the same as muscle weakness, although the two conditions can co-exist. Evidence: TAS. Frequency: Very frequent (HP:0040281). (ORPHA:1642)
- Global developmental delay (HP:0001263): A delay in the achievement of motor or mental milestones in the domains of development of a child, including motor skills, speech and language, cognitive skills, and social and emotional skills. This term should only be used to describe children younger than five years of age. Evidence: TAS. Frequency: Very frequent (HP:0040281). (ORPHA:1642)
- High, narrow palate (HP:0002705): The presence of a high and narrow palate. Evidence: TAS. Frequency: Very frequent (HP:0040281). (ORPHA:1642)
These phenotypes are associated with the disease Distal deletion 9p syndrome (ORPHA:1642).